- Cleft palate (HP:0000175): Cleft palate is a developmental defect of the palate resulting from a failure of fusion of the palatine processes and manifesting as a separation of the roof of the mouth (soft and hard palate). Evidence: PCS. Onset: Congenital onset (HP:0003577). (PMID:15354328)
- Cleft upper lip (HP:0000204): A gap or groove in the upper lip. This is a congenital defect resulting from nonfusion of tissues of the lip during embryonal development. Evidence: PCS. Onset: Congenital onset (HP:0003577). (PMID:15354328)
- Autosomal dominant inheritance (HP:0000006): A mode of inheritance that is observed for traits related to a gene encoded on one of the autosomes (i.e., the human chromosomes 1-22) in which a trait manifests in heterozygotes. In the context of medical genetics, an autosomal dominant disorder is caused when a single copy of the mutant allele is present. Males and females are affected equally, and can both transmit the disorder with a risk of 50% for each child of inheriting the mutant allele. Evidence: PCS. (PMID:10742093)
These phenotypes are associated with the disease orofacial cleft 5 (OMIM:608874).